Phenotypes associated with the disease lung cancer (OMIM:211980):
- Non-small cell lung carcinoma (HP:0030358). Evidence: TAS. (OMIM:211980)
- Typified by somatic mosaicism (HP:0001442): Description of conditions in which affected individuals typically display somatic mosaicism, i.e., genetically distinct populations of somatic cells in a given organism caused by DNA mutations, epigenetic alterations of DNA, chromosomal abnormalities or the spontaneous reversion of inherited mutations. In many conditions typified by somatic mosaicism, constitutive mutation is lethal and cases are exclusively or predominantly mosaic. Evidence: TAS. (OMIM:211980)
- Alveolar cell carcinoma (HP:0006519): Adenocarcinoma of the Bronchus. Evidence: TAS. (OMIM:211980)
- Lung adenocarcinoma (HP:0030078). Evidence: TAS. (OMIM:211980)
- Autosomal dominant inheritance (HP:0000006): A mode of inheritance that is observed for traits related to a gene encoded on one of the autosomes (i.e., the human chromosomes 1-22) in which a trait manifests in heterozygotes. In the context of medical genetics, an autosomal dominant disorder is caused when a single copy of the mutant allele is present. Males and females are affected equally, and can both transmit the disorder with a risk of 50% for each child of inheriting the mutant allele. Evidence: TAS. (OMIM:211980)